- Wide mouth (HP:0000154): Distance between the oral commissures more than 2 SD above the mean. Alternatively, an apparently increased width of the oral aperture (subjective). Evidence: TAS. Frequency: Occasional (HP:0040283). (ORPHA:93474)
- Everted lower lip vermilion (HP:0000232): An abnormal configuration of the lower lip such that it is turned outward i.e., everted, with the Inner aspect of the lower lip vermilion (normally opposing the teeth) being visible in a frontal view. Evidence: TAS. Frequency: Frequent (HP:0040282). (ORPHA:93474)
- Coarse facial features (HP:0000280): Absence of fine and sharp appearance of brows, nose, lips, mouth, and chin, usually because of rounded and heavy features or thickened skin with or without thickening of subcutaneous and bony tissues. Evidence: TAS. Frequency: Frequent (HP:0040282). (ORPHA:93474)
- Sensorineural hearing impairment (HP:0000407): A type of hearing impairment in one or both ears related to an abnormal functionality of the cochlear nerve. Evidence: TAS. Frequency: Occasional (HP:0040283). (ORPHA:93474)
- Glaucoma (HP:0000501): Glaucoma refers loss of retinal ganglion cells in a characteristic pattern of optic neuropathy usually associated with increased intraocular pressure. Evidence: TAS. Frequency: Very frequent (HP:0040281). (ORPHA:93474)
- Abnormality of the skeletal system (HP:0000924): An abnormality of the skeletal system. Evidence: TAS. Frequency: Very frequent (HP:0040281). (ORPHA:93474)
- Limitation of joint mobility (HP:0001376): A reduction in the freedom of movement of one or more joints. Evidence: TAS. Frequency: Very frequent (HP:0040281). (ORPHA:93474)
- Joint stiffness (HP:0001387): Joint stiffness is a perceived sensation of tightness in a joint or joints when attempting to move them after a period of inactivity. Joint stiffness typically subsides over time. Evidence: TAS. Frequency: Occasional (HP:0040283). (ORPHA:93474)
- Aortic regurgitation (HP:0001659): An insufficiency of the aortic valve, leading to regurgitation (backward flow) of blood from the aorta into the left ventricle. Evidence: TAS. Frequency: Very frequent (HP:0040281). (ORPHA:93474)
- Splenomegaly (HP:0001744): Abnormal increased size of the spleen. Evidence: TAS. Frequency: Frequent (HP:0040282). (ORPHA:93474)
- Hepatomegaly (HP:0002240): Abnormally increased size of the liver. Evidence: TAS. Frequency: Frequent (HP:0040282). (ORPHA:93474)
- Spastic paraparesis (HP:0002313): Partial loss of the ability to move the lower limbs accompanied by spasticity of the lower limbs. Evidence: TAS. Frequency: Occasional (HP:0040283). (ORPHA:93474)
- Corneal opacity (HP:0007957): A reduction of corneal clarity. Evidence: TAS. Frequency: Very frequent (HP:0040281). (ORPHA:93474)
- Mucopolysacchariduria (HP:0008155): Excessive amounts of mucopolysaccharide in the urine. Evidence: TAS. Frequency: Very frequent (HP:0040281). (ORPHA:93474)
- Rhinitis (HP:0012384): Inflammation of the nasal mucosa with nasal congestion. Evidence: TAS. Frequency: Occasional (HP:0040283). (ORPHA:93474)
- Thick vermilion border (HP:0012471): Increased width of the skin of vermilion border region of upper lip. Evidence: TAS. Frequency: Frequent (HP:0040282). (ORPHA:93474)
- Abnormal nerve conduction velocity (HP:0040129). Evidence: TAS. Frequency: Very frequent (HP:0040281). (ORPHA:93474)
- Cerebral palsy (HP:0100021): Cerebral palsy describes a group of permanent disorders of the development of movement and posture, causing activity limitation, that are attributed to nonprogressive disturbances that occurred in the developing fetal or infant brain. The motor disorders of cerebral palsy are often accompanied by disturbances of sensation, perception, cognition, communication, and behavior, by epilepsy, and by secondary musculoskeletal problems. Evidence: TAS. Frequency: Very frequent (HP:0040281). (ORPHA:93474)
These phenotypes are associated with the disease Scheie syndrome (ORPHA:93474).